Phenotypes associated with the disease developmental and epileptic encephalopathy, 81 (OMIM:618663):
- Myopathic facies (HP:0002058): A facial appearance characteristic of myopathic conditions. The face appears expressionless with sunken cheeks, bilateral ptosis, and inability to elevate the corners of the mouth, due to muscle weakness. Evidence: PCS. Frequency: 4/6. (PMID:31688942)
- Epicanthus (HP:0000286): A fold of skin starting above the medial aspect of the upper eyelid and arching downward to cover, pass in front of and lateral to the medial canthus. Evidence: PCS. Frequency: 6/6. (PMID:31688942)
- Congenital onset (HP:0003577): A phenotypic abnormality that is present at birth. Evidence: PCS. (PMID:31688942)
- Downslanted palpebral fissures (HP:0000494): The palpebral fissure inclination is more than two standard deviations below the mean. Evidence: PCS. Frequency: 6/6. (PMID:31688942)
- Focal clonic seizure (HP:0002266): A focal clonic seizure is a type of focal motor seizure characterized by sustained rhythmic jerking, that is regularly repetitive. Evidence: PCS. Frequency: 2/6. (PMID:31688942)
- Profound intellectual disability (HP:0002187): Profound intellectual disability (ID) is defined as a type of ID characterized by profoundly sub-average adaptive functioning and intellectual functioning, with an intelligence quotient (IQ) below 20. Evidence: PCS. Frequency: 6/6. (PMID:31688942)
- Small forehead (HP:0000350): The presence of a forehead that is abnormally small. Evidence: PCS. Frequency: 4/6. (PMID:31688942)
- Severe muscular hypotonia (HP:0006829): A severe degree of muscular hypotonia characterized by markedly reduced muscle tone. Evidence: PCS. Frequency: 6/6. (PMID:31688942)
- Global developmental delay (HP:0001263): A delay in the achievement of motor or mental milestones in the domains of development of a child, including motor skills, speech and language, cognitive skills, and social and emotional skills. This term should only be used to describe children younger than five years of age. Evidence: PCS. Frequency: 6/6. (PMID:31688942)
- Myoclonic seizure (HP:0032794): A myoclonic seizure is a type of motor seizure characterized by sudden, brief (<100 ms) involuntary single or multiple contraction of muscles or muscle groups of variable topography (axial, proximal limb, distal). Myoclonus is less regularly repetitive and less sustained than is clonus. Evidence: PCS. Frequency: 3/6. (PMID:31688942)
- EEG with burst suppression (HP:0010851): The burst suppression pattern in electroencephalography refers to a characteristic periodic pattern of low voltage (<10 microvolts) suppressed background and a relatively shorter pattern of higher amplitude slow, sharp, and spiking complexes. Evidence: PCS. Frequency: 6/6. (PMID:31688942)
- Infantile spasms (HP:0012469): Infantile spasms represent a subset of "epileptic spasms". Infantile Spasms are epileptic spasms starting in the first year of life (infancy). Evidence: PCS. Frequency: 5/6. (PMID:31688942)
- Sensorineural hearing impairment (HP:0000407): A type of hearing impairment in one or both ears related to an abnormal functionality of the cochlear nerve. Evidence: PCS. Frequency: 5/6. (PMID:31688942)
- Tonic seizure (HP:0032792): A tonic seizure is a type of motor seizure characterized by unilateral or bilateral limb stiffening or elevation, often with neck stiffening. Evidence: PCS. Frequency: 3/6. (PMID:31688942)
- Concave nasal ridge (HP:0011120): Nasal ridge curving posteriorly to an imaginary line that connects the nasal root and tip. Evidence: PCS. Frequency: 4/6. (PMID:31688942)
- Peripheral neuropathy (HP:0009830): Peripheral neuropathy is a general term for any disorder of the peripheral nervous system. The main clinical features used to classify peripheral neuropathy are distribution, type (mainly demyelinating versus mainly axonal), duration, and course. Evidence: PCS. Frequency: 5/5. (PMID:31688942)
- Autosomal recessive inheritance (HP:0000007): A mode of inheritance that is observed for traits related to a gene encoded on one of the autosomes (i.e., the human chromosomes 1-22) in which a trait manifests in individuals with two pathogenic alleles, either homozygotes (two copies of the same mutant allele) or compound heterozygotes (whereby each copy of a gene has a distinct mutant allele). Evidence: PCS. (PMID:31688942)
- High palate (HP:0000218): Height of the palate more than 2 SD above the mean (objective) or palatal height at the level of the first permanent molar more than twice the height of the teeth (subjective). Evidence: PCS. Frequency: 4/6. (PMID:31688942)
- Dolichocephaly (HP:0000268): An abnormality of skull shape characterized by a increased anterior-posterior diameter, i.e., an increased antero-posterior dimension of the skull. Cephalic index less than 76%. Alternatively, an apparently increased antero-posterior length of the head compared to width. Often due to premature closure of the sagittal suture. Evidence: PCS. Frequency: 2/6. (PMID:31688942)